- Decreased nerve conduction velocity (HP:0000762): A reduction in the speed at which electrical signals propagate along the axon of a neuron. Evidence: TAS. Frequency: Frequent (HP:0040282). (ORPHA:99944)
- Gait disturbance (HP:0001288): The term gait disturbance can refer to any disruption of the ability to walk. Evidence: TAS. Frequency: Frequent (HP:0040282). (ORPHA:99944)
- Distal muscle weakness (HP:0002460): Reduced strength of the musculature of the distal extremities. Evidence: TAS. Frequency: Frequent (HP:0040282). (ORPHA:99944)
- Distal sensory impairment (HP:0002936): An abnormal reduction in sensation in the distal portions of the extremities. Evidence: TAS. Frequency: Frequent (HP:0040282). (ORPHA:99944)
- Skeletal muscle atrophy (HP:0003202): The presence of skeletal muscular atrophy (which is also known as amyotrophy). Evidence: TAS. Frequency: Frequent (HP:0040282). (ORPHA:99944)
- Proximal muscle weakness (HP:0003701): A lack of strength of the proximal muscles. Evidence: TAS. Frequency: Frequent (HP:0040282). (ORPHA:99944)
- Hand muscle atrophy (HP:0009130): Muscular atrophy involving the muscles of the hand. Evidence: TAS. Frequency: Frequent (HP:0040282). (ORPHA:99944)
- Peripheral demyelination (HP:0011096): A loss of myelin from the internode regions along myelinated nerve fibers of the peripheral nervous system. Evidence: TAS. Frequency: Frequent (HP:0040282). (ORPHA:99944)
- Arrhythmia (HP:0011675): Any cardiac rhythm other than the normal sinus rhythm. Such a rhythm may be either of sinus or ectopic origin and either regular or irregular. An arrhythmia may be due to a disturbance in impulse formation or conduction or both. Evidence: TAS. Frequency: Frequent (HP:0040282). (ORPHA:99944)
- Motor delay (HP:0001270): A type of Developmental delay characterized by a delay in acquiring motor skills. Evidence: TAS. Frequency: Occasional (HP:0040283). (ORPHA:99944)
These phenotypes are associated with the disease Autosomal dominant Charcot-Marie-Tooth disease type 2K (ORPHA:99944).